- Hypertriglyceridemia (HP:0002155): An abnormal increase in the level of triglycerides in the blood. Evidence: PCS. (PMID:17332414)
- Elevated circulating LDL-C concentration (HP:0003141): The concentration of low-density lipoprotein cholesterol in the blood circulation is above the upper limit of normal. Evidence: PCS. (PMID:17332414)
- Adult onset (HP:0003581): Onset of disease manifestations in adulthood, defined here as at the age of 16 years or later. Evidence: PCS. (PMID:17332414)
- Impaired glucose tolerance (HP:0040270): An abnormal resistance to glucose, i.e., a reduction in the ability to maintain glucose levels in the blood stream within normal limits following oral or intravenous administration of glucose. Evidence: IEA. (OMIM:610947)
- Premature coronary artery atherosclerosis (HP:0005181): Reduction of the diameter of the coronary arteries as the result of an accumulation of atheromatous plaques within the walls of the coronary arteries before age of 45. Evidence: PCS. (PMID:17332414)
- Osteoporosis (HP:0000939): Osteoporosis is a systemic skeletal disease characterized by low bone density and microarchitectural deterioration of bone tissue with a consequent increase in bone fragility. According to the WHO criteria, osteoporosis is defined as a BMD that lies 2.5 standard deviations or more below the average value for young healthy adults (a T-score below -2.5 SD). Evidence: PCS. (PMID:17332414)
- Hypertension (HP:0000822): The presence of chronic increased pressure in the systemic arterial system. Evidence: PCS. (PMID:17332414)
- Myocardial infarction (HP:0001658): Necrosis of the myocardium caused by an obstruction of the blood supply to the heart and often associated with chest pain, shortness of breath, palpitations, and anxiety as well as characteristic EKG findings and elevation of serum markers including creatine kinase-MB fraction and troponin. Evidence: TAS. (OMIM:610947)
- Type II diabetes mellitus (HP:0005978): A type of diabetes mellitus initially characterized by insulin resistance and hyperinsulinemia and subsequently by glucose interolerance and hyperglycemia. Evidence: PCS. Frequency: 11/15. (PMID:17332414)
- Autosomal dominant inheritance (HP:0000006): A mode of inheritance that is observed for traits related to a gene encoded on one of the autosomes (i.e., the human chromosomes 1-22) in which a trait manifests in heterozygotes. In the context of medical genetics, an autosomal dominant disorder is caused when a single copy of the mutant allele is present. Males and females are affected equally, and can both transmit the disorder with a risk of 50% for each child of inheriting the mutant allele. Evidence: PCS. (PMID:17332414)
- Gout (HP:0001997): Recurrent attacks of acute inflammatory arthritis of a joint or set of joints caused by elevated levels of uric acid in the blood which crystallize and are deposited in joints, tendons, and surrounding tissues. Evidence: TAS. (OMIM:610947)
- Sudden cardiac death (HP:0001645): The heart suddenly and unexpectedly stops beating resulting in death within a short time period (generally within 1 h of symptom onset). Evidence: TAS. (OMIM:610947)
- Glucose intolerance (HP:0001952): Glucose intolerance (GI) can be defined as dysglycemia that comprises both prediabetes and diabetes. It includes the conditions of impaired fasting glucose (IFG) and impaired glucose tolerance (IGT) and diabetes mellitus (DM). Evidence: TAS. (OMIM:610947)
These phenotypes are associated with the disease coronary artery disease, autosomal dominant 2 (OMIM:610947).